Phenotypes associated with the disease complement component C1s deficiency (OMIM:613783):
- Systemic lupus erythematosus (HP:0002725): A chronic, relapsing, inflammatory, and often febrile multisystemic disorder of connective tissue, characterized principally by involvement of the skin, joints, kidneys, and serosal membranes. Evidence: TAS. (OMIM:613783)
- Hashimoto thyroiditis (HP:0000872): A chronic, autoimmune type of thyroiditis associated with hypothyroidism. Evidence: TAS. (OMIM:613783)
- Hepatitis (HP:0012115): Inflammation of the liver. Evidence: TAS. (OMIM:613783)
- Abnormality of complement system (HP:0005339): An abnormality of the complement system. Evidence: TAS. (OMIM:613783)